Phenotypes associated with the disease esophagitis, eosinophilic, 1 (OMIM:610247):
- Dysphagia (HP:0002015): Difficulty in swallowing. Evidence: PCS. (PMID:16453027)
- Vomiting (HP:0002013): Forceful ejection of the contents of the stomach through the mouth by means of a series of involuntary spasmic contractions. Evidence: PCS. (PMID:16453027)
- Failure to thrive (HP:0001508): Failure to thrive (FTT) refers to a child whose physical growth is substantially below the norm. Evidence: TAS. (OMIM:610247)
- Eosinophilic infiltration of the esophagus (HP:0410151): Infiltration of numerous eosinophils (usually greater than 15 per high power field) into the squamous epithelium of the esophagus, and layering of eosinophils on the surface layer of the esophagus. Evidence: PCS. (PMID:16453027)
- Epigastric pain (HP:0410019): Pain that is localized to the region of the upper abdomen immediately below the ribs. Evidence: PCS. (PMID:16453027)